Phenotypes associated with the disease hearing loss, autosomal recessive 99 (OMIM:618481):
- Congenital onset (HP:0003577): A phenotypic abnormality that is present at birth. Evidence: PCS. Frequency: 2/2. (PMID:25331638)
- Abnormal vestibular function (HP:0001751): An abnormality of the functioning of the vestibular apparatus. Evidence: PCS. Frequency: 2/2. (PMID:25331638)
- Sensorineural hearing impairment (HP:0000407): A type of hearing impairment in one or both ears related to an abnormal functionality of the cochlear nerve. Evidence: PCS. Frequency: 2/2. (PMID:25331638)
- Autosomal recessive inheritance (HP:0000007): A mode of inheritance that is observed for traits related to a gene encoded on one of the autosomes (i.e., the human chromosomes 1-22) in which a trait manifests in individuals with two pathogenic alleles, either homozygotes (two copies of the same mutant allele) or compound heterozygotes (whereby each copy of a gene has a distinct mutant allele). Evidence: PCS. (PMID:25331638)